Phenotypes associated with the disease immunodeficiency 106, susceptibility to viral infections (OMIM:619935):
- Juvenile onset (HP:0003621): Onset of signs or symptoms of disease between the age of 5 and 15 years. Evidence: PCS. Frequency: 1/2. (PMID:31270247)
- Post-vaccination measles (HP:0020088): Infection with the measles virus of the live-attenuated vaccine. This is an extremely rare event and may indicate immunocompromise in some cases. Evidence: PCS. Frequency: 1/1. (PMID:31270247)
- Infantile onset (HP:0003593): Onset of signs or symptoms of disease between 28 days to one year of life. Evidence: PCS. Frequency: 1/2. (PMID:31270247)
- Post-vaccination yellow fever (HP:0034310): Infection with the yellow fever virus of the live-attenuated vaccine. Evidence: PCS. Frequency: 1/1. (PMID:31270247)
- Autosomal recessive inheritance (HP:0000007): A mode of inheritance that is observed for traits related to a gene encoded on one of the autosomes (i.e., the human chromosomes 1-22) in which a trait manifests in individuals with two pathogenic alleles, either homozygotes (two copies of the same mutant allele) or compound heterozygotes (whereby each copy of a gene has a distinct mutant allele). Evidence: PCS. (PMID:31270247)